- Vitiligo (HP:0001045). Evidence: IEA. (OMIM:193200)
- Nevus (HP:0003764): A nevus is a type of hamartoma that is a circumscribed stable malformation of the skin. Evidence: IEA. (OMIM:193200)
- Autosomal recessive inheritance (HP:0000007): A mode of inheritance that is observed for traits related to a gene encoded on one of the autosomes (i.e., the human chromosomes 1-22) in which a trait manifests in individuals with two pathogenic alleles, either homozygotes (two copies of the same mutant allele) or compound heterozygotes (whereby each copy of a gene has a distinct mutant allele). Evidence: TAS. (OMIM:193200)
These phenotypes are associated with the disease vitiligo-associated multiple autoimmune disease susceptibility 6 (OMIM:193200).